Phenotypes associated with the disease mitochondrial complex III deficiency nuclear type 7 (OMIM:615824):
- Poor speech (HP:0002465). Evidence: TAS. (OMIM:615824)
- Epicanthus (HP:0000286): A fold of skin starting above the medial aspect of the upper eyelid and arching downward to cover, pass in front of and lateral to the medial canthus. Evidence: PCS. Frequency: 1/1. (PMID:24385928)
- Upslanted palpebral fissure (HP:0000582): The palpebral fissure inclination is more than two standard deviations above the mean for age (objective); or, the inclination of the palpebral fissure is greater than typical for age. Evidence: PCS. Frequency: 1/1. (PMID:24385928)
- Seizure (HP:0001250): A seizure is an intermittent abnormality of nervous system physiology characterized by a transient occurrence of signs and/or symptoms due to abnormal excessive or synchronous neuronal activity in the brain. Evidence: PCS. Frequency: 2/2. (PMID:28804536;PMID:24385928)
- Hypotonia (HP:0001252): Hypotonia is an abnormally low muscle tone (the amount of tension or resistance to movement in a muscle). Even when relaxed, muscles have a continuous and passive partial contraction which provides some resistance to passive stretching. Hypotonia thus manifests as diminished resistance to passive stretching. Hypotonia is not the same as muscle weakness, although the two conditions can co-exist. Evidence: PCS. Frequency: 1/1. (PMID:28804536)
- Failure to thrive (HP:0001508): Failure to thrive (FTT) refers to a child whose physical growth is substantially below the norm. Evidence: PCS. Frequency: 1/1. (PMID:28804536)
- Aggressive behavior (HP:0000718): Behavior or an act aimed at harming a person, animal, or physical property (e.g., acts of physical violence; shouting, swearing, and using harsh language; slashing someone's tires). Evidence: PCS. Frequency: 1/1. (PMID:24385928)
- Decreased activity of mitochondrial complex II (HP:0008314): A reduction in the activity of the mitochondrial respiratory chain complex II, which is part of the electron transport chain in mitochondria. Evidence: PCS. Frequency: 0/1. (PMID:24385928)
- Hyperactivity (HP:0000752): Hyperactivity is a condition characterized by constant and unusually high levels of activity, even in situations where it is deemed inappropriate. Evidence: TAS. (OMIM:615824)
- Metabolic acidosis (HP:0001942): Metabolic acidosis (MA) is characterized by a fall in blood pH due to a reduction of serum bicarbonate concentration. This can occur as a result of either the accumulation of acids (high anion gap MA) or the loss of bicarbonate from the gastrointestinal tract or the kidney (hyperchloremic MA). By definition, MA is not due to a respirary cause. Evidence: TAS. (OMIM:615824)
- Breech presentation (HP:0001623): A position of the fetus at delivery in which the fetus enters the birth canal with the buttocks or feet first. Evidence: PCS. Frequency: 1/1. (PMID:28804536)
- Neonatal onset (HP:0003623): Onset of signs or symptoms of disease within the first 28 days of life. Evidence: PCS. Frequency: 2/2. (PMID:28804536;PMID:24385928)
- Lactic acidosis (HP:0003128): An abnormal buildup of lactic acid in the body, leading to acidification of the blood and other bodily fluids. Evidence: PCS. Frequency: 1/1. (PMID:28804536)
- Oligohydramnios (HP:0001562): Diminished amniotic fluid volume in pregnancy. Evidence: PCS. Frequency: 1/1. (PMID:28804536)
- Status epilepticus (HP:0002133): Status epilepticus is a type of prolonged seizure resulting either from the failure of the mechanisms responsible for seizure termination or from the initiation of mechanisms which lead to abnormally prolonged seizures (after time point t1). It is a condition that can have long-term consequences (after time point t2), including neuronal death, neuronal injury, and alteration of neuronal networks, depending on the type and duration of seizures. Evidence: PCS. Frequency: 1/1. (PMID:28804536)
- Vomiting (HP:0002013): Forceful ejection of the contents of the stomach through the mouth by means of a series of involuntary spasmic contractions. Evidence: PCS. Frequency: 1/1. (PMID:28804536)
- Decreased activity of mitochondrial complex III (HP:0011924): A reduction in the activity of the mitochondrial respiratory chain complex III, which is part of the electron transport chain in mitochondria. Evidence: PCS. Frequency: 1/1. (PMID:24385928)
- Increased circulating lactate concentration (HP:0002151): Abnormally increased level of blood lactate (2-hydroxypropanoic acid). Lactate is produced from pyruvate by lactate dehydrogenase during normal metabolism. The terms lactate and lactic acid are often used interchangeably but lactate (the component measured in blood) is strictly a weak base whereas lactic acid is the corresponding acid. Lactic acidosis is often used clinically to describe elevated lactate but should be reserved for cases where there is a corresponding acidosis (pH below 7.35). Evidence: PCS. Frequency: 1/1. (PMID:24385928)
- Global developmental delay (HP:0001263): A delay in the achievement of motor or mental milestones in the domains of development of a child, including motor skills, speech and language, cognitive skills, and social and emotional skills. This term should only be used to describe children younger than five years of age. Evidence: PCS. Frequency: 1/1. (PMID:24385928)
- Increased CSF lactate (HP:0002490): Increased concentration of lactate in the cerebrospinal fluid. Evidence: PCS. Frequency: 1/1. (PMID:24385928)
- Decreased activity of mitochondrial complex I (HP:0011923): A reduction in the activity of the mitochondrial respiratory chain complex I, which is part of the electron transport chain in mitochondria. Evidence: PCS. Frequency: 1/1. (PMID:24385928)
- Depressed nasal bridge (HP:0005280): Posterior positioning of the nasal root in relation to the overall facial profile for age. Evidence: PCS. Frequency: 1/1. (PMID:24385928)
- Postaxial polydactyly (HP:0100259): A form of polydactyly in which the extra digit or digits are localized on the side of the fifth finger or fifth toe. Evidence: TAS. (OMIM:615824)
- Sensorineural hearing impairment (HP:0000407): A type of hearing impairment in one or both ears related to an abnormal functionality of the cochlear nerve. Evidence: PCS. Frequency: 1/1. (PMID:24385928)
- Autosomal recessive inheritance (HP:0000007): A mode of inheritance that is observed for traits related to a gene encoded on one of the autosomes (i.e., the human chromosomes 1-22) in which a trait manifests in individuals with two pathogenic alleles, either homozygotes (two copies of the same mutant allele) or compound heterozygotes (whereby each copy of a gene has a distinct mutant allele). Evidence: PCS. (PMID:24385928)
- Neonatal hypotonia (HP:0001319): Muscular hypotonia (abnormally low muscle tone) manifesting in the neonatal period. Evidence: PCS. Frequency: 1/1. (PMID:28804536)
- Decreased activity of mitochondrial complex IV (HP:0008347): A reduction in the activity of the mitochondrial respiratory chain complex IV, which is part of the electron transport chain in mitochondria. Evidence: PCS. Frequency: 1/1. (PMID:24385928)
- Congenital lactic acidosis (HP:0004902): A form of lactic acidemia with congenital onset. Evidence: PCS. Frequency: 1/1. Onset: Neonatal onset (HP:0003623). (PMID:24385928)
- Synophrys (HP:0000664): Meeting of the medial eyebrows in the midline. Evidence: PCS. Frequency: 1/1. (PMID:24385928)
- Intrauterine growth retardation (HP:0001511): An abnormal restriction of fetal growth with fetal weight below the tenth percentile for gestational age. Evidence: PCS. Frequency: 2/2. (PMID:28804536;PMID:24385928)
- Proximal renal tubular acidosis (HP:0002049): A type of renal tubular acidosis characterized by a failure of the proximal tubular cells to reabsorb bicarbonate, leading to urinary bicarbonate wasting and subsequent acidemia. Evidence: PCS. Frequency: 1/1. (PMID:24385928)
- Cryptorchidism (HP:0000028): Testis in inguinal canal. That is, absence of one or both testes from the scrotum owing to failure of the testis or testes to descend through the inguinal canal to the scrotum. Evidence: PCS. Frequency: 1/1. (PMID:24385928)